Phenotypes associated with the disease Mucous membrane pemphigoid (ORPHA:46486):
- Gingivitis (HP:0000230): Inflammation of the gingiva. Evidence: TAS. Frequency: Frequent (HP:0040282). (ORPHA:46486)
- Blindness (HP:0000618): Blindness is the condition of lacking visual perception defined as a profound reduction in visual perception. On the 6m visual acuity scale, blindness is defined as less than 3/60. On the 20ft visual acuity scale, blindness is defined as less than 20/400. On the decimal visual acuity scale, blindness is defined as less than 0.05. Blindness is typically characterized by a visual field of no greater than 10 degrees in radius around central fixation. Evidence: TAS. Frequency: Occasional (HP:0040283). (ORPHA:46486)
- Atypical scarring of skin (HP:0000987): Atypically scarred skin . Evidence: TAS. Frequency: Frequent (HP:0040282). (ORPHA:46486)
- Autoimmunity (HP:0002960): The occurrence of an immune reaction against the organism's own cells or tissues. Evidence: TAS. Frequency: Very frequent (HP:0040281). (ORPHA:46486)
- Corneal opacity (HP:0007957): A reduction of corneal clarity. Evidence: TAS. Frequency: Occasional (HP:0040283). (ORPHA:46486)
- Abnormal blistering of the skin (HP:0008066): The presence of one or more bullae on the skin, defined as fluid-filled blisters more than 5 mm in diameter with thin walls. Evidence: TAS. Frequency: Occasional (HP:0040283). (ORPHA:46486)
- Oral mucosal blisters (HP:0200097): Blisters arising in the mouth. Evidence: TAS. Frequency: Very frequent (HP:0040281). (ORPHA:46486)